Phenotypes associated with the disease Microcephaly-seizures-intellectual disability-heart disease syndrome (ORPHA:2519):
- Micropenis (HP:0000054): Abnormally small penis. At birth, the normal penis is about 3 cm (stretched length from pubic tubercle to tip of penis) with micropenis less than 2.0-2.5 cm. Evidence: TAS. Frequency: Very frequent (HP:0040281). (ORPHA:2519)
- Congenital hypothyroidism (HP:0000851): A type of hypothyroidism with congenital onset. Evidence: TAS. Frequency: Very frequent (HP:0040281). (ORPHA:2519)
- Intellectual disability (HP:0001249): The term intellectual disability or intellectual developmental disorder is used to describe significantly sub-average intellectual and adaptive functioning based on clinical assessment and as measured by individually administered, appropriately normed, standardized and validated tests of intellectual functioning and adaptive behavior, with onset during the developmental period from infancy through adolescence. Evidence: TAS. Frequency: Very frequent (HP:0040281). (ORPHA:2519)
- Seizure (HP:0001250): A seizure is an intermittent abnormality of nervous system physiology characterized by a transient occurrence of signs and/or symptoms due to abnormal excessive or synchronous neuronal activity in the brain. Evidence: TAS. Frequency: Very frequent (HP:0040281). (ORPHA:2519)
- Global developmental delay (HP:0001263): A delay in the achievement of motor or mental milestones in the domains of development of a child, including motor skills, speech and language, cognitive skills, and social and emotional skills. This term should only be used to describe children younger than five years of age. Evidence: TAS. Frequency: Very frequent (HP:0040281). (ORPHA:2519)
- Atrial septal defect (HP:0001631): Atrial septal defect (ASD) is a congenital abnormality of the interatrial septum that enables blood flow between the left and right atria via the interatrial septum. Evidence: TAS. Frequency: Very frequent (HP:0040281). (ORPHA:2519)
- Congenital nystagmus (HP:0006934): Nystagmus dating from or present at birth. Evidence: TAS. Frequency: Very frequent (HP:0040281). (ORPHA:2519)
- Floppy infant (HP:0008947): Floppiness/hypotonia is defined as reduced resistance to passive movement of joints. Physical examination of floppy/hypotonic infants shows head lag, lack of shoulder and elbow muscle contraction on traction response, inability to tighten the shoulder girdle muscles (or slipping through) when held under the axillae, scarf sign (when the arm is pulled to the opposite side, the arm wraps around the neck with the elbow crossing midline), hyperdorsiflexion of the feet, easy apposition of the thumb against the forearm, feet touching the cheek with ease and without discomfort, frog leg position, and inverted U sign on ventral suspension (head, arms, and legs hanging down without elbow or knee flexion and the trunk rounded in a dome shape). Evidence: TAS. Frequency: Very frequent (HP:0040281). (ORPHA:2519)
- Cryptorchidism (HP:0000028): Testis in inguinal canal. That is, absence of one or both testes from the scrotum owing to failure of the testis or testes to descend through the inguinal canal to the scrotum. Evidence: TAS. Frequency: Frequent (HP:0040282). (ORPHA:2519)
- Microcephaly (HP:0000252): Head circumference below 2 standard deviations below the mean for age and gender. Evidence: TAS. Frequency: Frequent (HP:0040282). (ORPHA:2519)
- Epicanthus (HP:0000286): A fold of skin starting above the medial aspect of the upper eyelid and arching downward to cover, pass in front of and lateral to the medial canthus. Evidence: TAS. Frequency: Frequent (HP:0040282). (ORPHA:2519)
- Esotropia (HP:0000565): A form of strabismus with one or both eyes turned inward ('crossed') to a relatively severe degree, usually defined as 10 diopters or more. Evidence: TAS. Frequency: Frequent (HP:0040282). (ORPHA:2519)
- Abnormal sternum morphology (HP:0000766): An anomaly of the sternum, also known as the breastbone. Evidence: TAS. Frequency: Frequent (HP:0040282). (ORPHA:2519)
- Abnormal rib morphology (HP:0000772): An anomaly of the rib. Evidence: TAS. Frequency: Frequent (HP:0040282). (ORPHA:2519)
- Short ribs (HP:0000773): Reduced rib length. Evidence: TAS. Frequency: Frequent (HP:0040282). (ORPHA:2519)
- Broad ribs (HP:0000885): Increased width of ribs. Evidence: TAS. Frequency: Frequent (HP:0040282). (ORPHA:2519)
- Postaxial hand polydactyly (HP:0001162): Supernumerary digits located at the ulnar side of the hand (that is, on the side with the fifth finger). Evidence: TAS. Frequency: Frequent (HP:0040282). (ORPHA:2519)
- Ventricular septal defect (HP:0001629): A hole between the two bottom chambers (ventricles) of the heart. The defect is centered around the most superior aspect of the ventricular septum. Evidence: TAS. Frequency: Frequent (HP:0040282). (ORPHA:2519)
- Patent ductus arteriosus (HP:0001643): In utero, the ductus arteriosus (DA) serves to divert ventricular output away from the lungs and toward the placenta by connecting the main pulmonary artery to the descending aorta. A patent ductus arteriosus (PDA) in the first 3 days of life is a physiologic shunt in healthy term and preterm newborn infants, and normally is substantially closed within about 24 hours after bith and completely closed after about three weeks. Failure of physiologcal closure is referred to a persistent or patent ductus arteriosus (PDA). Depending on the degree of left-to-right shunting, PDA can have clinical consequences. Evidence: TAS. Frequency: Frequent (HP:0040282). (ORPHA:2519)
- Hypoplasia of the corpus callosum (HP:0002079): Underdevelopment of the corpus callosum. Evidence: TAS. Frequency: Frequent (HP:0040282). (ORPHA:2519)
- Pulmonary arterial hypertension (HP:0002092): Pulmonary hypertension is defined mean pulmonary artery pressure of 25mmHg or more and pulmonary capillary wedge pressure of 15mmHg or less when measured by right heart catheterisation at rest and in a supine position. Evidence: TAS. Frequency: Frequent (HP:0040282). (ORPHA:2519)
- Respiratory distress (HP:0002098): Respiratory distress is objectively observable as the physical or emotional consequences from the experience of dyspnea. The physical presentation of respiratory distress is generally referred to as labored breathing, while the sensation of respiratory distress is called shortness of breath or dyspnea. Evidence: TAS. Frequency: Frequent (HP:0040282). (ORPHA:2519)
- Supernumerary nipple (HP:0002558): Presence of more than two nipples. Evidence: TAS. Frequency: Frequent (HP:0040282). (ORPHA:2519)
- Redundant neck skin (HP:0005989): Excess skin around the neck, often lying in horizontal folds. Evidence: TAS. Frequency: Frequent (HP:0040282). (ORPHA:2519)